- Hypoplasia of the ulna (HP:0003022): Underdevelopment of the ulna. Evidence: TAS. (OMIM:191440)
- Ulnar deviation of the hand (HP:0009487): Divergence of the longitudinal axis of the hand at the wrist in a posterior (ulnar) direction (i.e., towards the little finger). Evidence: TAS. (OMIM:191440)
- Distal ulnar hypoplasia (HP:0005033): Underdevelopment of the distal portion of the ulna. Evidence: TAS. (OMIM:191440)
- Mesomelic arm shortening (HP:0005011): Shortening of the middle parts of the arm in relation to the upper and terminal segments. Evidence: TAS. (OMIM:191440)
- Radial ray deficiency (HP:0006433): Radial dysplasia, also known as radial longitudinal deficiency, includes radial clubhand and is a disfiguring, and potentially disabling, congenital limb anomaly. The entire upper limb may be involved, although the defect is most evident in the forearm and hand. Affected children suffer a variable degree of hypoplasia or absence of the preaxial skeleton and soft tissues, in particular the thumb, radius, and dorsoradial soft tissues. The hand is usually radially deviated and subluxated off the distal aspect of the ulna, the ulna may be shortened and have a bow-shaped deformity, and there is no true wrist (radiocarpal) joint in Bayne2 type-III and IV radial dysplasia. Evidence: TAS. (OMIM:191440)
- Radial bowing (HP:0002986): A bending or abnormal curvature of the radius. Evidence: TAS. Onset: Adult onset (HP:0003581). (OMIM:191440)
- Autosomal dominant inheritance (HP:0000006): A mode of inheritance that is observed for traits related to a gene encoded on one of the autosomes (i.e., the human chromosomes 1-22) in which a trait manifests in heterozygotes. In the context of medical genetics, an autosomal dominant disorder is caused when a single copy of the mutant allele is present. Males and females are affected equally, and can both transmit the disorder with a risk of 50% for each child of inheriting the mutant allele. Evidence: TAS. (OMIM:191440)
- Hypoplasia of the radius (HP:0002984): Underdevelopment of the radius. Evidence: TAS. (OMIM:191440)
These phenotypes are associated with the disease upper limb mesomelic dysplasia (OMIM:191440).